Phenotypes associated with the disease Progressive nodular histiocytosis (ORPHA:158022):
- Subcutaneous nodule (HP:0001482): Slightly elevated lesions on or in the skin with a diameter of over 5 mm. Evidence: TAS. Frequency: Very frequent (HP:0040281). (ORPHA:158022)
- Fever (HP:0001945): Body temperature elevated above the normal range. Evidence: TAS. Frequency: Occasional (HP:0040283). (ORPHA:158022)
- Cachexia (HP:0004326): Severe weight loss, wasting of muscle, loss of appetite, and general debility related to a chronic disease. Evidence: TAS. Frequency: Occasional (HP:0040283). (ORPHA:158022)
- Papule (HP:0200034): A circumscribed, solid elevation of skin with no visible fluid, varying in size from a pinhead to less than 10mm in diameter at the widest point. Evidence: TAS. Frequency: Very frequent (HP:0040281). (ORPHA:158022)